Phenotypes associated with the disease Karsch-Neugebauer syndrome (OMIM:183800):
- Congenital nystagmus (HP:0006934): Nystagmus dating from or present at birth. Evidence: IEA. (OMIM:183800)
- Strabismus (HP:0000486): A misalignment of the eyes so that the visual axes deviate from bifoveal fixation. The classification of strabismus may be based on a number of features including the relative position of the eyes, whether the deviation is latent or manifest, intermittent or constant, concomitant or otherwise and according to the age of onset and the relevance of any associated refractive error. Evidence: IEA. (OMIM:183800)
- Hand monodactyly (HP:0004058). Evidence: IEA. (OMIM:183800)
- Cataract (HP:0000518): A cataract is an opacity or clouding that develops in the crystalline lens of the eye or in its capsule. Evidence: IEA. (OMIM:183800)
- Nystagmus (HP:0000639): Rhythmic, involuntary oscillations of one or both eyes related to abnormality in fixation, conjugate gaze, or vestibular mechanisms. Evidence: PCS. (PMID:9450888)
- Split foot (HP:0001839): A condition in which middle parts of the foot (toes and metatarsals) are missing giving a cleft appearance. The severity is very variable ranging from slightly hypoplastic 3rd toe over absent 2nd or 3rd toes as far as oligo- or monodactyl feet. Evidence: IEA. (OMIM:183800)
- Split hand (HP:0001171): A condition in which middle parts of the hand (fingers and metacarpals) are missing giving a cleft appearance. The severity is very variable ranging from slightly hypoplastic middle fingers over absent middle fingers as far as oligo- or monodactyl hands. Evidence: IEA. (OMIM:183800)
- Retinopathy (HP:0000488): Any noninflammatory disease of the retina. This nonspecific term is retained here because of its wide use in the literature, but if possible new annotations should indicate the precise type of retinal abnormality. Evidence: TAS. (OMIM:183800)
- Autosomal dominant inheritance (HP:0000006): A mode of inheritance that is observed for traits related to a gene encoded on one of the autosomes (i.e., the human chromosomes 1-22) in which a trait manifests in heterozygotes. In the context of medical genetics, an autosomal dominant disorder is caused when a single copy of the mutant allele is present. Males and females are affected equally, and can both transmit the disorder with a risk of 50% for each child of inheriting the mutant allele. Evidence: IEA. (OMIM:183800)